Phenotypes associated with the disease myopia 15, autosomal dominant (OMIM:612717):
- Autosomal dominant inheritance (HP:0000006): A mode of inheritance that is observed for traits related to a gene encoded on one of the autosomes (i.e., the human chromosomes 1-22) in which a trait manifests in heterozygotes. In the context of medical genetics, an autosomal dominant disorder is caused when a single copy of the mutant allele is present. Males and females are affected equally, and can both transmit the disorder with a risk of 50% for each child of inheriting the mutant allele. Evidence: IEA. (OMIM:612717)
- Myopia (HP:0000545): An abnormality of refraction characterized by the ability to see objects nearby clearly, while objects in the distance appear blurry. Evidence: IEA. (OMIM:612717)